Phenotypes associated with the disease X-linked cone-rod dystrophy 2 (OMIM:300085):
- Cone dystrophy (HP:0008020): Inherited progressive cone degeneration. Evidence: TAS. (OMIM:300085)
- Cone/cone-rod dystrophy (HP:0000548). Evidence: TAS. (OMIM:300085)
- X-linked inheritance (HP:0001417): A mode of inheritance that is observed for traits related to a gene encoded on the X chromosome. Evidence: TAS. (OMIM:300085)